Phenotypes associated with the disease WAC-related facial dysmorphism-developmental delay-behavioral abnormalities syndrome (ORPHA:466943):
- Atypical behavior (HP:0000708): Atypical behavior is an abnormality in a person's actions that can be controlled or modulated by the will of the individual. While abnormal behaviors can be difficult to control, they are distinct from other abnormal actions that cannot be affected by the individual's will. Evidence: TAS. Frequency: Very frequent (HP:0040281). (ORPHA:466943)
- Intellectual disability (HP:0001249): The term intellectual disability or intellectual developmental disorder is used to describe significantly sub-average intellectual and adaptive functioning based on clinical assessment and as measured by individually administered, appropriately normed, standardized and validated tests of intellectual functioning and adaptive behavior, with onset during the developmental period from infancy through adolescence. Evidence: TAS. Frequency: Very frequent (HP:0040281). (ORPHA:466943)
- Global developmental delay (HP:0001263): A delay in the achievement of motor or mental milestones in the domains of development of a child, including motor skills, speech and language, cognitive skills, and social and emotional skills. This term should only be used to describe children younger than five years of age. Evidence: TAS. Frequency: Very frequent (HP:0040281). (ORPHA:466943)
- Abnormal facial shape (HP:0001999): An abnormal morphology (form) of the face or its components. Evidence: TAS. Frequency: Very frequent (HP:0040281). (ORPHA:466943)
- Floppy infant (HP:0008947): Floppiness/hypotonia is defined as reduced resistance to passive movement of joints. Physical examination of floppy/hypotonic infants shows head lag, lack of shoulder and elbow muscle contraction on traction response, inability to tighten the shoulder girdle muscles (or slipping through) when held under the axillae, scarf sign (when the arm is pulled to the opposite side, the arm wraps around the neck with the elbow crossing midline), hyperdorsiflexion of the feet, easy apposition of the thumb against the forearm, feet touching the cheek with ease and without discomfort, frog leg position, and inverted U sign on ventral suspension (head, arms, and legs hanging down without elbow or knee flexion and the trunk rounded in a dome shape). Evidence: TAS. Frequency: Very frequent (HP:0040281). (ORPHA:466943)
- Square face (HP:0000321): Facial contours, as viewed from the front, show a broad upper face/cranium and lower face/mandible, creating a square appearance. Evidence: TAS. Frequency: Frequent (HP:0040282). (ORPHA:466943)
- Abnormality of the outer ear (HP:0000356): An abnormality of the external ear. Evidence: TAS. Frequency: Frequent (HP:0040282). (ORPHA:466943)
- Strabismus (HP:0000486): A misalignment of the eyes so that the visual axes deviate from bifoveal fixation. The classification of strabismus may be based on a number of features including the relative position of the eyes, whether the deviation is latent or manifest, intermittent or constant, concomitant or otherwise and according to the age of onset and the relevance of any associated refractive error. Evidence: TAS. Frequency: Frequent (HP:0040282). (ORPHA:466943)
- Abnormality of vision (HP:0000504): Abnormality of eyesight (visual perception). Evidence: TAS. Frequency: Frequent (HP:0040282). (ORPHA:466943)
- Anxiety (HP:0000739): Intense feelings of nervousness, tension, or panic often arise in response to interpersonal stresses. There is worry about the negative effects of past unpleasant experiences and future negative possibilities. Individuals may feel fearful, apprehensive, or threatened by uncertainty, and they may also have fears of falling apart or losing control. Evidence: TAS. Frequency: Frequent (HP:0040282). (ORPHA:466943)
- Delayed speech and language development (HP:0000750): A degree of language development that is significantly below the norm for a child of a specified age. Evidence: TAS. Frequency: Frequent (HP:0040282). (ORPHA:466943)
- Seizure (HP:0001250): A seizure is an intermittent abnormality of nervous system physiology characterized by a transient occurrence of signs and/or symptoms due to abnormal excessive or synchronous neuronal activity in the brain. Evidence: TAS. Frequency: Frequent (HP:0040282). (ORPHA:466943)
- Absent speech (HP:0001344): Complete lack of development of speech and language abilities. Evidence: TAS. Frequency: Frequent (HP:0040282). (ORPHA:466943)
- Constipation (HP:0002019): Infrequent or difficult evacuation of feces. Evidence: TAS. Frequency: Frequent (HP:0040282). (ORPHA:466943)
- Delayed gross motor development (HP:0002194): A type of motor delay characterized by a delay in acquiring the ability to control the large muscles of the body for walking, running, sitting, and crawling. Evidence: TAS. Frequency: Frequent (HP:0040282). (ORPHA:466943)
- Sleep disturbance (HP:0002360): An abnormal pattern in the quality, quantity, or characteristics of sleep. Evidence: TAS. Frequency: Frequent (HP:0040282). (ORPHA:466943)
- Gastrointestinal dysmotility (HP:0002579): Abnormal intestinal contractions, such as spasms and intestinal paralysis, related to the loss of the ability of the gut to coordinate muscular activity because of endogenous or exogenous causes. Evidence: TAS. Frequency: Frequent (HP:0040282). (ORPHA:466943)
- Attention deficit hyperactivity disorder (HP:0007018): Attention deficit hyperactivity disorder (ADHD) manifests at age 2-3 years or by first grade at the latest. The main symptoms are distractibility, impulsivity, hyperactivity, and often trouble organizing tasks and projects, difficulty going to sleep, and social problems from being aggressive, loud, or impatient. Evidence: TAS. Frequency: Frequent (HP:0040282). (ORPHA:466943)
- Delayed fine motor development (HP:0010862): A type of motor delay characterized by a delay in acquiring the ability to control the fingers and hands. Evidence: TAS. Frequency: Frequent (HP:0040282). (ORPHA:466943)
- Feeding difficulties (HP:0011968): Impaired ability to eat related to problems gathering food and getting ready to suck, chew, or swallow it. Evidence: TAS. Frequency: Frequent (HP:0040282). (ORPHA:466943)
- Oral motor hypotonia (HP:0030190): Reduced muscle tone of oral musculature. In infants, this feature may be associated with difficulties in breast feeding, and may affect the latch, jaw motions, tongue placement, lip seal, suck/swallow/breathe pattern and overall feeding behavior. Evidence: TAS. Frequency: Frequent (HP:0040282). (ORPHA:466943)
- Wide mouth (HP:0000154): Distance between the oral commissures more than 2 SD above the mean. Alternatively, an apparently increased width of the oral aperture (subjective). Evidence: TAS. Frequency: Occasional (HP:0040283). (ORPHA:466943)
- Thin upper lip vermilion (HP:0000219): Height of the vermilion of the upper lip in the midline more than 2 SD below the mean. Alternatively, an apparently reduced height of the vermilion of the upper lip in the frontal view (subjective). Evidence: TAS. Frequency: Occasional (HP:0040283). (ORPHA:466943)
- Epicanthus (HP:0000286): A fold of skin starting above the medial aspect of the upper eyelid and arching downward to cover, pass in front of and lateral to the medial canthus. Evidence: TAS. Frequency: Occasional (HP:0040283). (ORPHA:466943)
- Hypertelorism (HP:0000316): Interpupillary distance more than 2 SD above the mean (alternatively, the appearance of an increased interpupillary distance or widely spaced eyes). Evidence: TAS. Frequency: Occasional (HP:0040283). (ORPHA:466943)
- Posteriorly rotated ears (HP:0000358): A type of abnormal location of the ears in which the position of the ears is characterized by posterior rotation (the superior part of the ears is rotated towards the back of the head, and the inferior part of the ears towards the front). Evidence: TAS. Frequency: Occasional (HP:0040283). (ORPHA:466943)
- Prominent antihelix (HP:0000395): The presence of an abnormally prominent antihelix. Evidence: TAS. Frequency: Occasional (HP:0040283). (ORPHA:466943)
- Bulbous nose (HP:0000414): Increased volume and globular shape of the anteroinferior aspect of the nose. Evidence: TAS. Frequency: Occasional (HP:0040283). (ORPHA:466943)
- Wide nasal bridge (HP:0000431): Increased breadth of the nasal bridge (and with it, the nasal root). Evidence: TAS. Frequency: Occasional (HP:0040283). (ORPHA:466943)
- Broad nasal tip (HP:0000455): Increase in width of the nasal tip. Evidence: TAS. Frequency: Occasional (HP:0040283). (ORPHA:466943)
- Astigmatism (HP:0000483): A type of refraction error associated with abnormal curvatures on the anterior and/or posterior surface of the cornea. Evidence: TAS. Frequency: Occasional (HP:0040283). (ORPHA:466943)
- Deeply set eye (HP:0000490): An eye that is more deeply recessed into the plane of the face than is typical. Evidence: TAS. Frequency: Occasional (HP:0040283). (ORPHA:466943)
- Myopia (HP:0000545): An abnormality of refraction characterized by the ability to see objects nearby clearly, while objects in the distance appear blurry. Evidence: TAS. Frequency: Occasional (HP:0040283). (ORPHA:466943)
- Long palpebral fissure (HP:0000637): Distance between medial and lateral canthi is more than two standard deviations above the mean for age (objective); or, apparently increased length of the palpebral fissures. Evidence: TAS. Frequency: Occasional (HP:0040283). (ORPHA:466943)
- Synophrys (HP:0000664): Meeting of the medial eyebrows in the midline. Evidence: TAS. Frequency: Occasional (HP:0040283). (ORPHA:466943)
- Aggressive behavior (HP:0000718): Behavior or an act aimed at harming a person, animal, or physical property (e.g., acts of physical violence; shouting, swearing, and using harsh language; slashing someone's tires). Evidence: TAS. Frequency: Occasional (HP:0040283). (ORPHA:466943)
- Autistic behavior (HP:0000729): Persistent deficits in social interaction and communication and interaction as well as a markedly restricted repertoire of activity and interest as well as repetitive patterns of behavior. Evidence: TAS. Frequency: Occasional (HP:0040283). (ORPHA:466943)
- Brachydactyly (HP:0001156): Digits that appear disproportionately short compared to the hand/foot. The word brachydactyly is used here to describe a series distinct patterns of shortened digits (brachydactyly types A-E). This is the sense used here. Evidence: TAS. Frequency: Occasional (HP:0040283). (ORPHA:466943)
- Dysarthria (HP:0001260): Dysarthric speech is a general description referring to a neurological speech disorder characterized by poor articulation. Depending on the involved neurological structures, dysarthria may be further classified as spastic, flaccid, ataxic, hyperkinetic and hypokinetic, or mixed. Evidence: TAS. Frequency: Occasional (HP:0040283). (ORPHA:466943)
- Obesity (HP:0001513): Accumulation of substantial excess body fat. Evidence: TAS. Frequency: Occasional (HP:0040283). (ORPHA:466943)
- Dysphagia (HP:0002015): Difficulty in swallowing. Evidence: TAS. Frequency: Occasional (HP:0040283). (ORPHA:466943)
- Gastroesophageal reflux (HP:0002020): A condition in which the stomach contents leak backwards from the stomach into the esophagus through the lower esophageal sphincter. Evidence: TAS. Frequency: Occasional (HP:0040283). (ORPHA:466943)
- Asthma (HP:0002099): Asthma is characterized by increased responsiveness of the tracheobronchial tree to multiple stimuli, leading to narrowing of the air passages with resultant dyspnea, cough, and wheezing. Evidence: TAS. Frequency: Occasional (HP:0040283). (ORPHA:466943)
- Ventriculomegaly (HP:0002119): An increase in size of the ventricular system of the brain. Evidence: TAS. Frequency: Occasional (HP:0040283). (ORPHA:466943)
- Moderate intellectual disability (HP:0002342): Moderate intellectual disability (ID) is defined as a type of ID characterized by moderately sub-average adaptive functioning and intellectual functioning, with an intelligence quotient (IQ) the range of 35-49. Evidence: TAS. Frequency: Occasional (HP:0040283). (ORPHA:466943)
- Incoordination (HP:0002311): A deficit in coordination of muscle movements. Coordination is defined as the orchestrated movement of multiple body parts as required to accomplish intended actions, like walking. Evidence: TAS. Frequency: Occasional (HP:0040283). (ORPHA:466943)
- Downturned corners of mouth (HP:0002714): A morphological abnormality of the mouth in which the angle of the mouth is downturned. The oral commissures are positioned inferior to the midline labial fissure. Evidence: TAS. Frequency: Occasional (HP:0040283). (ORPHA:466943)
- Recurrent infections (HP:0002719): Increased susceptibility to infections as manifested by repeated bouts of infection. Evidence: TAS. Frequency: Occasional (HP:0040283). (ORPHA:466943)
- Inverted nipples (HP:0003186): The presence of nipples that instead of pointing outward are retracted inwards. Evidence: TAS. Frequency: Occasional (HP:0040283). (ORPHA:466943)
- Depressed nasal bridge (HP:0005280): Posterior positioning of the nasal root in relation to the overall facial profile for age. Evidence: TAS. Frequency: Occasional (HP:0040283). (ORPHA:466943)
- Borderline intellectual disability (HP:0006889): Borderline intellectual disability is defined as an intelligence quotient (IQ) in the range of 70-85. Evidence: TAS. Frequency: Occasional (HP:0040283). (ORPHA:466943)
- Prominent forehead (HP:0011220): Forward prominence of the entire forehead, due to protrusion of the frontal bone. Evidence: TAS. Frequency: Occasional (HP:0040283). (ORPHA:466943)
- Broad chin (HP:0011822): Increased width of the midpoint of the mandible (mental protuberance) and overlying soft tissue. Evidence: TAS. Frequency: Occasional (HP:0040283). (ORPHA:466943)
- Widened subarachnoid space (HP:0012704): An increase in size of the anatomic space between the arachnoid membrane and pia mater. Evidence: TAS. Frequency: Occasional (HP:0040283). (ORPHA:466943)
- Nasal flaring (HP:0030863): Widening of the nostrils upon inhalation as a manifestation of respiratory distress. Evidence: TAS. Frequency: Occasional (HP:0040283). (ORPHA:466943)
- Nasogastric tube feeding (HP:0040288): The condition of inability to eat normally treated by placement of a thin tube through the nose into the stomach that is then used to carry food. Evidence: TAS. Frequency: Occasional (HP:0040283). (ORPHA:466943)
- Cerebral visual impairment (HP:0100704): A form of loss of vision caused by damage to the visual cortex rather than a defect in the eye. Evidence: TAS. Frequency: Occasional (HP:0040283). (ORPHA:466943)
- Self-injurious behavior (HP:0100716): Self-aggression. Evidence: TAS. Frequency: Occasional (HP:0040283). (ORPHA:466943)
- Pelvic kidney (HP:0000125): A developmental defect in which a kidney is located in an abnormal anatomic position within the pelvis. Evidence: TAS. Frequency: Very rare (HP:0040284). (ORPHA:466943)
- Conductive hearing impairment (HP:0000405): An abnormality of vibrational conductance of sound to the inner ear leading to impairment of sensory perception of sound. Evidence: TAS. Frequency: Very rare (HP:0040284). (ORPHA:466943)
- Sensorineural hearing impairment (HP:0000407): A type of hearing impairment in one or both ears related to an abnormal functionality of the cochlear nerve. Evidence: TAS. Frequency: Very rare (HP:0040284). (ORPHA:466943)
- Single transverse palmar crease (HP:0000954): The distal and proximal transverse palmar creases are merged into a single transverse palmar crease. Evidence: TAS. Frequency: Very rare (HP:0040284). (ORPHA:466943)
- Pes planus (HP:0001763): A foot where the longitudinal arch of the foot is in contact with the ground or floor when the individual is standing; or, in a patient lying supine, a foot where the arch is in contact with the surface of a flat board pressed against the sole of the foot by the examiner with a pressure similar to that expected from weight bearing; or, the height of the arch is reduced. Evidence: TAS. Frequency: Very rare (HP:0040284). (ORPHA:466943)
- Bilateral tonic-clonic seizure (HP:0002069): A bilateral tonic-clonic seizure is a seizure defined by a tonic (bilateral increased tone, lasting seconds to minutes) and then a clonic (bilateral sustained rhythmic jerking) phase. Evidence: TAS. Frequency: Very rare (HP:0040284). (ORPHA:466943)
- Generalized non-motor (absence) seizure (HP:0002121): A generalized non-motor (absence) seizure is a type of a type of dialeptic seizure that is of electrographically generalized onset. It is a generalized seizure characterized by an interruption of activities, a blank stare, and usually the person will be unresponsive when spoken to. Any ictal motor phenomena are minor in comparison to these non-motor features. Evidence: TAS. Frequency: Very rare (HP:0040284). (ORPHA:466943)
- Febrile seizure (within the age range of 3 months to 6 years) (HP:0002373): A febrile seizure is any type of seizure (most often a generalized tonic-clonic seizure) occurring with fever (at least 38 degrees Celsius) but in the absence of central nervous system infection, severe metabolic disturbance or other alternative precipitant in children between the ages of 3 months and 6 years. Evidence: TAS. Frequency: Very rare (HP:0040284). (ORPHA:466943)
- Short palm (HP:0004279): Short palm. Evidence: TAS. Frequency: Very rare (HP:0040284). (ORPHA:466943)
- Pes valgus (HP:0008081): An outward (valgus) deviation of the calcaneus relative to the longitudinal axis of the lower leg at the talocalcaneal (subtalar) joint, such that the heel is everted. Evidence: TAS. Frequency: Very rare (HP:0040284). (ORPHA:466943)
- Dilatation of renal calices (HP:0100581): An abnormal enlargement of the renal calices, the system of ducts of the kidney that collect urine. Evidence: TAS. Frequency: Very rare (HP:0040284). (ORPHA:466943)
- Arachnoid cyst (HP:0100702): An extra-parenchymal and intra-arachnoidal collection of fluid with a composition similar to that of cerebrospinal fluid. Evidence: TAS. Frequency: Very rare (HP:0040284). (ORPHA:466943)